- Female infertility (HP:0008222). Evidence: PCS. (PMID:29895852)
- Autosomal recessive inheritance (HP:0000007): A mode of inheritance that is observed for traits related to a gene encoded on one of the autosomes (i.e., the human chromosomes 1-22) in which a trait manifests in individuals with two pathogenic alleles, either homozygotes (two copies of the same mutant allele) or compound heterozygotes (whereby each copy of a gene has a distinct mutant allele). Evidence: PCS. (PMID:29895852)
- Thin zona pellucida (HP:0020157): Reduced thickness of the zona pellucida. Evidence: PCS. (PMID:29895852)
These phenotypes are associated with the disease oocyte maturation defect 6 (OMIM:618353).